Phenotypes associated with the disease Car factor deficiency (OMIM:114650):
- Abnormal bleeding (HP:0001892): An abnormal susceptibility to bleeding, often referred to as a bleeding diathesis. A bleeding diathesis may be related to vascular, platelet and coagulation defects. Evidence: TAS. (OMIM:114650)
- Autosomal dominant inheritance (HP:0000006): A mode of inheritance that is observed for traits related to a gene encoded on one of the autosomes (i.e., the human chromosomes 1-22) in which a trait manifests in heterozygotes. In the context of medical genetics, an autosomal dominant disorder is caused when a single copy of the mutant allele is present. Males and females are affected equally, and can both transmit the disorder with a risk of 50% for each child of inheriting the mutant allele. Evidence: IEA. (OMIM:114650)